Phenotypes associated with the disease Prominent glabella-microcephaly-hypogenitalism syndrome (ORPHA:2083):
- Cryptorchidism (HP:0000028): Testis in inguinal canal. That is, absence of one or both testes from the scrotum owing to failure of the testis or testes to descend through the inguinal canal to the scrotum. Evidence: TAS. Frequency: Very frequent (HP:0040281). (ORPHA:2083)
- Small scrotum (HP:0000046): Apparently small scrotum for age. Evidence: TAS. Frequency: Very frequent (HP:0040281). (ORPHA:2083)
- Hydronephrosis (HP:0000126): Severe distention of the kidney with dilation of the renal pelvis and calices. Evidence: TAS. Frequency: Frequent (HP:0040282). (ORPHA:2083)
- Microcephaly (HP:0000252): Head circumference below 2 standard deviations below the mean for age and gender. Evidence: TAS. Frequency: Very frequent (HP:0040281). (ORPHA:2083)
- Dolichocephaly (HP:0000268): An abnormality of skull shape characterized by a increased anterior-posterior diameter, i.e., an increased antero-posterior dimension of the skull. Cephalic index less than 76%. Alternatively, an apparently increased antero-posterior length of the head compared to width. Often due to premature closure of the sagittal suture. Evidence: TAS. Frequency: Very frequent (HP:0040281). (ORPHA:2083)
- Micrognathia (HP:0000347): Developmental hypoplasia of the mandible. Evidence: TAS. Frequency: Very frequent (HP:0040281). (ORPHA:2083)
- Posteriorly rotated ears (HP:0000358): A type of abnormal location of the ears in which the position of the ears is characterized by posterior rotation (the superior part of the ears is rotated towards the back of the head, and the inferior part of the ears towards the front). Evidence: TAS. Frequency: Very frequent (HP:0040281). (ORPHA:2083)
- Overfolded helix (HP:0000396): A condition in which the helix is folded over to a greater degree than normal. That is, excessive curling of the helix edge, whereby the free edge is parallel to the plane of the ear. Evidence: TAS. Frequency: Very frequent (HP:0040281). (ORPHA:2083)
- Macrotia (HP:0000400): Median longitudinal ear length greater than two standard deviations above the mean and median ear width greater than two standard deviations above the mean (objective); or, apparent increase in length and width of the pinna (subjective). Evidence: TAS. Frequency: Very frequent (HP:0040281). (ORPHA:2083)
- Prominent nasal bridge (HP:0000426): Anterior positioning of the nasal root in comparison to the usual positioning for age. Evidence: TAS. Frequency: Very frequent (HP:0040281). (ORPHA:2083)
- Underdeveloped nasal alae (HP:0000430): Thinned, deficient, or excessively arched ala nasi. Evidence: TAS. Frequency: Frequent (HP:0040282). (ORPHA:2083)
- Short neck (HP:0000470): Diminished length of the neck. Evidence: TAS. Frequency: Frequent (HP:0040282). (ORPHA:2083)
- Thickened nuchal skin fold (HP:0000474): A thickening of the skin thickness in the posterior aspect of the fetal neck. A nuchal fold (NF) measurement is obtained in a transverse section of the fetal head at the level of the cavum septum pellucidum and thalami, angled posteriorly to include the cerebellum. The measurement is taken from the outer edge of the occiput bone to the outer skin limit directly in the midline. An NF measurement greater than 5 mm at 14 to 17+6 weeks of gestation, or 6 mm at 18 to 28 weeks has been associated with a markedly increased risk for Down syndrome. Evidence: TAS. Frequency: Frequent (HP:0040282). (ORPHA:2083)
- Brachydactyly (HP:0001156): Digits that appear disproportionately short compared to the hand/foot. The word brachydactyly is used here to describe a series distinct patterns of shortened digits (brachydactyly types A-E). This is the sense used here. Evidence: TAS. Frequency: Frequent (HP:0040282). (ORPHA:2083)
- Seizure (HP:0001250): A seizure is an intermittent abnormality of nervous system physiology characterized by a transient occurrence of signs and/or symptoms due to abnormal excessive or synchronous neuronal activity in the brain. Evidence: TAS. Frequency: Very frequent (HP:0040281). (ORPHA:2083)
- Global developmental delay (HP:0001263): A delay in the achievement of motor or mental milestones in the domains of development of a child, including motor skills, speech and language, cognitive skills, and social and emotional skills. This term should only be used to describe children younger than five years of age. Evidence: TAS. Frequency: Very frequent (HP:0040281). (ORPHA:2083)
- Hypertonia (HP:0001276): A condition in which there is increased muscle tone so that arms or legs, for example, are stiff and difficult to move. Evidence: TAS. Frequency: Very frequent (HP:0040281). (ORPHA:2083)
- Growth delay (HP:0001510): A deficiency or slowing down of growth pre- and postnatally. Evidence: TAS. Frequency: Very frequent (HP:0040281). (ORPHA:2083)
- Intrauterine growth retardation (HP:0001511): An abnormal restriction of fetal growth with fetal weight below the tenth percentile for gestational age. Evidence: TAS. Frequency: Very frequent (HP:0040281). (ORPHA:2083)
- Abnormality of the voice (HP:0001608). Evidence: TAS. Frequency: Frequent (HP:0040282). (ORPHA:2083)
- Prominent glabella (HP:0002057): Forward protrusion of the glabella. Evidence: TAS. Frequency: Very frequent (HP:0040281). (ORPHA:2083)
- Ventriculomegaly (HP:0002119): An increase in size of the ventricular system of the brain. Evidence: TAS. Frequency: Frequent (HP:0040282). (ORPHA:2083)
- Highly arched eyebrow (HP:0002553): Increased height of the central portion of the eyebrow, forming a crescent, semicircular, or inverted U shape. Evidence: TAS. Frequency: Very frequent (HP:0040281). (ORPHA:2083)
- Short nose (HP:0003196): Distance from nasion to subnasale more than two standard deviations below the mean, or alternatively, an apparently decreased length from the nasal root to the nasal tip. Evidence: TAS. Frequency: Very frequent (HP:0040281). (ORPHA:2083)
- Wide intermamillary distance (HP:0006610): A larger than usual distance between the left and right nipple. Evidence: TAS. Frequency: Very frequent (HP:0040281). (ORPHA:2083)
- Bilateral single transverse palmar creases (HP:0007598): The distal and proximal transverse palmar creases are merged into a single transverse palmar crease on both hands. Evidence: TAS. Frequency: Frequent (HP:0040282). (ORPHA:2083)
- Hypoplasia of penis (HP:0008736). Evidence: TAS. Frequency: Very frequent (HP:0040281). (ORPHA:2083)
- Abnormal hair pattern (HP:0010720): An abnormality of the distribution of hair growth. Evidence: TAS. Frequency: Very frequent (HP:0040281). (ORPHA:2083)
- Short palpebral fissure (HP:0012745): Distance between the medial and lateral canthi is more than 2 SD below the mean for age (objective); or, apparently reduced length of the palpebral fissures. Evidence: TAS. Frequency: Very frequent (HP:0040281). (ORPHA:2083)
- Camptodactyly of finger (HP:0100490): The distal interphalangeal joint and/or the proximal interphalangeal joint of the fingers cannot be extended to 180 degrees by either active or passive extension. Evidence: TAS. Frequency: Frequent (HP:0040282). (ORPHA:2083)
- Cognitive impairment (HP:0100543): Abnormal cognition is characterized by deficits in thinking, reasoning, or remembering. Evidence: TAS. Frequency: Very frequent (HP:0040281). (ORPHA:2083)